- Arthritis (HP:0001369): Inflammation of a joint. Evidence: TAS. Frequency: Frequent (HP:0040282). (ORPHA:85408)
- Joint swelling (HP:0001386). Evidence: TAS. Frequency: Frequent (HP:0040282). (ORPHA:85408)
- Joint stiffness (HP:0001387): Joint stiffness is a perceived sensation of tightness in a joint or joints when attempting to move them after a period of inactivity. Joint stiffness typically subsides over time. Evidence: TAS. Frequency: Frequent (HP:0040282). (ORPHA:85408)
- Ankle swelling (HP:0001785). Evidence: TAS. Frequency: Frequent (HP:0040282). (ORPHA:85408)
- Arthralgia (HP:0002829): Joint pain. Evidence: TAS. Frequency: Frequent (HP:0040282). (ORPHA:85408)
- Abnormality of the wrist (HP:0003019): Abnormality of the wrist, the structure connecting the hand and the forearm. Evidence: TAS. Frequency: Frequent (HP:0040282). (ORPHA:85408)
- Elevated erythrocyte sedimentation rate (HP:0003565): An increased erythrocyte sedimentation rate (ESR). The ESR is a test that measures the distance that erythrocytes have fallen after one hour in a vertical column of anticoagulated blood under the influence of gravity. The ESR is a nonspecific finding. An elevation may indicate inflammation or may be caused by any condition that elevates fibrinogen. Evidence: TAS. Frequency: Frequent (HP:0040282). (ORPHA:85408)
- Knee osteoarthritis (HP:0005086). Evidence: TAS. Frequency: Frequent (HP:0040282). (ORPHA:85408)
- Synovial lining hyperplasia (HP:0005186): Synovial hyperplasia involves proliferation of mesenchymal stromal/stem cells and leads to synovial thickening, which can be observed radiographically. Evidence: TAS. Frequency: Frequent (HP:0040282). (ORPHA:85408)
- Enthesitis (HP:0100686). Evidence: TAS. Frequency: Frequent (HP:0040282). (ORPHA:85408)
- Synovitis (HP:0100769). Evidence: TAS. Frequency: Frequent (HP:0040282). (ORPHA:85408)
- Uveitis (HP:0000554): Inflammation of one or all portions of the uveal tract. Evidence: TAS. Frequency: Occasional (HP:0040283). (ORPHA:85408)
- Abnormality of the hand (HP:0001155): An abnormality affecting one or both hands. Evidence: TAS. Frequency: Occasional (HP:0040283). (ORPHA:85408)
- Flexion contracture (HP:0001371): A flexion contracture is a bent (flexed) joint that cannot be straightened actively or passively. It is thus a chronic loss of joint motion due to structural changes in muscle, tendons, ligaments, or skin that prevents normal movement of joints. Evidence: TAS. Frequency: Occasional (HP:0040283). (ORPHA:85408)
- Abnormal hip joint morphology (HP:0001384): An abnormality of the hip joint. Evidence: TAS. Frequency: Occasional (HP:0040283). (ORPHA:85408)
- Mild postnatal growth retardation (HP:0001530): A mild degree of slow or limited growth after birth, being between two and three standard deviations below age- and sex-related norms. Evidence: TAS. Frequency: Occasional (HP:0040283). (ORPHA:85408)
- Weight loss (HP:0001824): Reduction of total body weight. Evidence: TAS. Frequency: Occasional (HP:0040283). (ORPHA:85408)
- Abnormal metatarsal morphology (HP:0001832): Abnormalities of the metatarsal bones (i.e. of five tubular bones located between the tarsal bones of the hind- and mid-foot and the phalanges of the toes). Evidence: TAS. Frequency: Occasional (HP:0040283). (ORPHA:85408)
- Anemia (HP:0001903): A reduction in erythrocytes volume or hemoglobin concentration. Evidence: TAS. Frequency: Occasional (HP:0040283). (ORPHA:85408)
- Lymphadenopathy (HP:0002716): Enlargement (swelling) of a lymph node. Evidence: TAS. Frequency: Occasional (HP:0040283). (ORPHA:85408)
- Abnormal shoulder morphology (HP:0003043): An abnormality of the shoulder, which is defined as the structures surrounding the shoulder joint where the humerus attaches to the scapula. Evidence: TAS. Frequency: Occasional (HP:0040283). (ORPHA:85408)
- Abnormality of the cervical spine (HP:0003319): Any abnormality of the cervical vertebral column. Evidence: TAS. Frequency: Occasional (HP:0040283). (ORPHA:85408)
- Myalgia (HP:0003326): Pain in muscle. Evidence: TAS. Frequency: Occasional (HP:0040283). (ORPHA:85408)
- Antinuclear antibody positivity (HP:0003493): The presence of autoantibodies in the serum that react against nuclei or nuclear components. Evidence: TAS. Frequency: Occasional (HP:0040283). (ORPHA:85408)
- Hip osteoarthritis (HP:0008843). Evidence: TAS. Frequency: Occasional (HP:0040283). (ORPHA:85408)
- Abnormality of the temporomandibular joint (HP:0010754): An anomaly of the temporomandibular joint. Evidence: TAS. Frequency: Occasional (HP:0040283). (ORPHA:85408)
- Low-grade fever (HP:0011134): Mild fever that does not exceed 38.5 degrees centigrade. Evidence: TAS. Frequency: Occasional (HP:0040283). (ORPHA:85408)
- Abnormal metacarpophalangeal joint morphology (HP:0011911): An anomaly of a metacarpophalangeal joint. Evidence: TAS. Frequency: Occasional (HP:0040283). (ORPHA:85408)
- Oligoarthritis (HP:0040313): A type of arthritis that affects up to four joints in the first six months of disease. Evidence: TAS. Frequency: Occasional (HP:0040283). (ORPHA:85408)
- Iridocyclitis (HP:0001094): A type of anterior uveitis, in which there is Inflammation of the iris and the ciliary body. Evidence: TAS. Frequency: Very rare (HP:0040284). (ORPHA:85408)
- Hepatosplenomegaly (HP:0001433): Simultaneous enlargement of the liver and spleen. Evidence: TAS. Frequency: Very rare (HP:0040284). (ORPHA:85408)
These phenotypes are associated with the disease Rheumatoid factor-negative polyarticular juvenile idiopathic arthritis (ORPHA:85408).